Phenotypes associated with the disease migraine with or without aura, susceptibility to, 10 (OMIM:610208):
- Vomiting (HP:0002013): Forceful ejection of the contents of the stomach through the mouth by means of a series of involuntary spasmic contractions. Evidence: IEA. (OMIM:610208)
- Migraine with aura (HP:0002077): A type of migraine in which there is an aura characterized by focal neurological phenomena that usually proceed, but may accompany or occur in the absence of, the headache. The symptoms of an aura may include fully reversible visual, sensory, and speech symptoms but not motor weakness. Visual symptoms may include flickering lights, spots and lines and/or loss of vision and/or unilateral sensory symptoms such as paresthesias or numbness. At least one of the symptoms of an aura develops gradually over 5 or more minutes and/or different symptoms occur in succession. Evidence: IEA. (OMIM:610208)
- Photophobia (HP:0000613): Excessive sensitivity to light with the sensation of discomfort or pain in the eyes due to exposure to bright light. Evidence: IEA. (OMIM:610208)
- Migraine without aura (HP:0002083): Repeated headache attacks lasting 4-72 h fulfilling at least two of the following criteria: 1) unilateral location, 2) pulsating quality, 3) moderate or severe pain intensity, and 4) aggravation by or causing avoidance of routine physical activity such as climbing stairs. Headache attacks are commonly accompanied by nausea, vomiting, photophobia, or phonophobia. Evidence: IEA. (OMIM:610208)
- Phonophobia (HP:0002183): An abnormally heightened sensitivity to loud sounds. Evidence: IEA. (OMIM:610208)
- Nausea (HP:0002018): A sensation of unease in the stomach together with an urge to vomit. Evidence: IEA. (OMIM:610208)
- Autosomal dominant inheritance (HP:0000006): A mode of inheritance that is observed for traits related to a gene encoded on one of the autosomes (i.e., the human chromosomes 1-22) in which a trait manifests in heterozygotes. In the context of medical genetics, an autosomal dominant disorder is caused when a single copy of the mutant allele is present. Males and females are affected equally, and can both transmit the disorder with a risk of 50% for each child of inheriting the mutant allele. Evidence: IEA. (OMIM:610208)